Phenotypes associated with the disease epilepsy, early-onset, vitamin B6-dependent (OMIM:617290):
- Hypertonia (HP:0001276): A condition in which there is increased muscle tone so that arms or legs, for example, are stiff and difficult to move. Evidence: PCS. Frequency: 3/7. (PMID:27912044)
- Poor speech (HP:0002465). Evidence: PCS. (PMID:27912044)
- Bilateral tonic-clonic seizure (HP:0002069): A bilateral tonic-clonic seizure is a seizure defined by a tonic (bilateral increased tone, lasting seconds to minutes) and then a clonic (bilateral sustained rhythmic jerking) phase. Evidence: PCS. Frequency: 5/7. (PMID:27912044)
- Upslanted palpebral fissure (HP:0000582): The palpebral fissure inclination is more than two standard deviations above the mean for age (objective); or, the inclination of the palpebral fissure is greater than typical for age. Evidence: PCS. Frequency: 1/4. (PMID:27912044)
- Long philtrum (HP:0000343): Distance between nasal base and midline upper lip vermilion border more than 2 SD above the mean. Alternatively, an apparently increased distance between nasal base and midline upper lip vermilion border. Evidence: PCS. Frequency: 1/4. (PMID:27912044)
- Hypotonia (HP:0001252): Hypotonia is an abnormally low muscle tone (the amount of tension or resistance to movement in a muscle). Even when relaxed, muscles have a continuous and passive partial contraction which provides some resistance to passive stretching. Hypotonia thus manifests as diminished resistance to passive stretching. Hypotonia is not the same as muscle weakness, although the two conditions can co-exist. Evidence: PCS. Frequency: 1/7. (PMID:27912044)
- Infantile onset (HP:0003593): Onset of signs or symptoms of disease between 28 days to one year of life. Evidence: PCS. Frequency: 1/7. (PMID:27912044)
- Myoclonic seizure (HP:0032794): A myoclonic seizure is a type of motor seizure characterized by sudden, brief (<100 ms) involuntary single or multiple contraction of muscles or muscle groups of variable topography (axial, proximal limb, distal). Myoclonus is less regularly repetitive and less sustained than is clonus. Evidence: PCS. Frequency: 3/7. (PMID:27912044)
- Motor delay (HP:0001270): A type of Developmental delay characterized by a delay in acquiring motor skills. Evidence: PCS. Frequency: 4/6. (PMID:27912044)
- Brain atrophy (HP:0012444): Partial or complete wasting (loss) of brain tissue that was once present. Evidence: PCS. Frequency: 1/7. (PMID:27912044)
- Irritability (HP:0000737): An emotional state characterized by negative feelings of heightened frustration, annoyance, or feeling upset, often triggered by internal factors (e.g., fatigue, hunger, unfulfilled desires) or external factors (e.g., social or environmental challenges). Irritability may be unpredictable, and is accompanied by a lowered threshold for emotional reactivity and observable features (speech, facial expressions, or psychomotor activity). Evidence: PCS. Frequency: 3/4. (PMID:27912044)
- Clonic seizure (HP:0020221): A clonic seizure is a type of motor seizure characterized by sustained rhythmic jerking, that is regularly repetitive. Evidence: PCS. Frequency: 1/7. (PMID:27912044)
- Esodeviation (HP:0020045): A manifest or latent ocular deviation in which one or both eyes tends to deviate nasally. Evidence: PCS. Frequency: 1/4. (PMID:27912044)
- Ventriculomegaly (HP:0002119): An increase in size of the ventricular system of the brain. Evidence: PCS. (PMID:27912044)
- Thin upper lip vermilion (HP:0000219): Height of the vermilion of the upper lip in the midline more than 2 SD below the mean. Alternatively, an apparently reduced height of the vermilion of the upper lip in the frontal view (subjective). Evidence: PCS. Frequency: 2/4. (PMID:27912044)
- Fetal distress (HP:0025116): An intrauterine state characterized by suboptimal values in the fetal heart rate, oxygenation of fetal blood, or other parameters indicative of compromise of the fetus. Signs of fetal distress include repetitive variable decelerations, fetal tachycardia or bradycardia, late decelerations, or low biophysical profile. Evidence: PCS. Frequency: 4/7. (PMID:27912044)
- Intellectual disability (HP:0001249): The term intellectual disability or intellectual developmental disorder is used to describe significantly sub-average intellectual and adaptive functioning based on clinical assessment and as measured by individually administered, appropriately normed, standardized and validated tests of intellectual functioning and adaptive behavior, with onset during the developmental period from infancy through adolescence. Evidence: PCS. (PMID:27912044)
- Metabolic acidosis (HP:0001942): Metabolic acidosis (MA) is characterized by a fall in blood pH due to a reduction of serum bicarbonate concentration. This can occur as a result of either the accumulation of acids (high anion gap MA) or the loss of bicarbonate from the gastrointestinal tract or the kidney (hyperchloremic MA). By definition, MA is not due to a respirary cause. Evidence: PCS. Frequency: 5/7. (PMID:27912044)
- Neonatal onset (HP:0003623): Onset of signs or symptoms of disease within the first 28 days of life. Evidence: PCS. Frequency: 6/7. (PMID:27912044)
- Delayed speech and language development (HP:0000750): A degree of language development that is significantly below the norm for a child of a specified age. Evidence: PCS. Frequency: 5/6. (PMID:27912044)
- Global developmental delay (HP:0001263): A delay in the achievement of motor or mental milestones in the domains of development of a child, including motor skills, speech and language, cognitive skills, and social and emotional skills. This term should only be used to describe children younger than five years of age. Evidence: PCS. Frequency: 7/7. (PMID:27912044)
- Increased circulating lactate concentration (HP:0002151): Abnormally increased level of blood lactate (2-hydroxypropanoic acid). Lactate is produced from pyruvate by lactate dehydrogenase during normal metabolism. The terms lactate and lactic acid are often used interchangeably but lactate (the component measured in blood) is strictly a weak base whereas lactic acid is the corresponding acid. Lactic acidosis is often used clinically to describe elevated lactate but should be reserved for cases where there is a corresponding acidosis (pH below 7.35). Evidence: PCS. Frequency: 4/6. (PMID:27912044)
- Secondary microcephaly (HP:0005484): Head circumference which falls below 2 standard deviations below the mean for age and gender because of insufficient head growth after birth. Evidence: PCS. Frequency: 6/7. (PMID:27912044)
- EEG with burst suppression (HP:0010851): The burst suppression pattern in electroencephalography refers to a characteristic periodic pattern of low voltage (<10 microvolts) suppressed background and a relatively shorter pattern of higher amplitude slow, sharp, and spiking complexes. Evidence: PCS. Frequency: 5/7. (PMID:27912044)
- Respiratory insufficiency (HP:0002093). Evidence: PCS. Frequency: 3/7. Onset: Neonatal onset (HP:0003623). (PMID:27912044)
- Tonic seizure (HP:0032792): A tonic seizure is a type of motor seizure characterized by unilateral or bilateral limb stiffening or elevation, often with neck stiffening. Evidence: PCS. Frequency: 4/4. (PMID:27912044)
- Periorbital fullness (HP:0000629): Increase in periorbital soft tissue. Evidence: PCS. Frequency: 1/4. (PMID:27912044)
- Autosomal recessive inheritance (HP:0000007): A mode of inheritance that is observed for traits related to a gene encoded on one of the autosomes (i.e., the human chromosomes 1-22) in which a trait manifests in individuals with two pathogenic alleles, either homozygotes (two copies of the same mutant allele) or compound heterozygotes (whereby each copy of a gene has a distinct mutant allele). Evidence: PCS. (PMID:27912044)
- Apnea (HP:0002104): Lack of breathing with no movement of the respiratory muscles and no exchange of air in the lungs. This term refers to a disposition to have recurrent episodes of apnea rather than to a single event. Evidence: PCS. Frequency: 1/7. Onset: Neonatal onset (HP:0003623). (PMID:27912044)
- Myoclonus (HP:0001336): Very brief, involuntary random muscular contractions occurring at rest, in response to sensory stimuli, or accompanying voluntary movements. Evidence: PCS. Frequency: 3/7. (PMID:27912044)